- Anaphylactic shock (HP:0100845): An acute hypersensitivity reaction due to exposure to a previously encountered antigen. Evidence: TAS. Frequency: Very rare (HP:0040284). (ORPHA:79457)
- Generalized abnormality of skin (HP:0011354): An abnormality of the skin that is not localized to any one particular region. Evidence: TAS. Frequency: Very frequent (HP:0040281). (ORPHA:79457)
- Darier's sign (HP:0025081): A skin change elicited by briskly rubbing the skin lesion in urticaria pigmentosa (UP), whereby the area begins to itch and becomes raised and surrounded by erythema. Unlike other forms of dermatographism, Darier's sign refers to urtication that is limited to the UP involved areas and, as in this case, spares the skin unaffected by UP. Evidence: TAS. Frequency: Very frequent (HP:0040281). (ORPHA:79457)
- Pruritus (HP:0000989): Pruritus is an itch or a sensation that makes a person want to scratch. This term refers to an abnormally increased disposition to experience pruritus. Evidence: TAS. Frequency: Frequent (HP:0040282). (ORPHA:79457)
- Erythema (HP:0010783): Redness of the skin, caused by hyperemia of the capillaries in the lower layers of the skin. Evidence: TAS. Frequency: Frequent (HP:0040282). (ORPHA:79457)
- Macule (HP:0012733): A flat, distinct, discolored area of skin less than 1 cm wide that does not involve any change in the thickness or texture of the skin. Evidence: TAS. Frequency: Frequent (HP:0040282). (ORPHA:79457)
- Yellow papule (HP:0025507): A papule with yellow color. Evidence: TAS. Frequency: Frequent (HP:0040282). (ORPHA:79457)
- Irritability (HP:0000737): An emotional state characterized by negative feelings of heightened frustration, annoyance, or feeling upset, often triggered by internal factors (e.g., fatigue, hunger, unfulfilled desires) or external factors (e.g., social or environmental challenges). Irritability may be unpredictable, and is accompanied by a lowered threshold for emotional reactivity and observable features (speech, facial expressions, or psychomotor activity). Evidence: TAS. Frequency: Occasional (HP:0040283). (ORPHA:79457)
- Fever (HP:0001945): Body temperature elevated above the normal range. Evidence: TAS. Frequency: Occasional (HP:0040283). (ORPHA:79457)
- Vomiting (HP:0002013): Forceful ejection of the contents of the stomach through the mouth by means of a series of involuntary spasmic contractions. Evidence: TAS. Frequency: Occasional (HP:0040283). (ORPHA:79457)
- Diarrhea (HP:0002014): Abnormally increased frequency (usually defined as three or more) loose or watery bowel movements a day. Evidence: TAS. Frequency: Occasional (HP:0040283). (ORPHA:79457)
- Nausea (HP:0002018): A sensation of unease in the stomach together with an urge to vomit. Evidence: TAS. Frequency: Occasional (HP:0040283). (ORPHA:79457)
- Abdominal pain (HP:0002027): An unpleasant sensation characterized by physical discomfort (such as pricking, throbbing, or aching) and perceived to originate in the abdomen. Evidence: TAS. Frequency: Occasional (HP:0040283). (ORPHA:79457)
- Headache (HP:0002315): Cephalgia, or pain sensed in various parts of the head, not confined to the area of distribution of any nerve. Evidence: TAS. Frequency: Occasional (HP:0040283). (ORPHA:79457)
- Bone pain (HP:0002653): An unpleasant sensation characterized by physical discomfort (such as pricking, throbbing, or aching) localized to bone. Evidence: TAS. Frequency: Occasional (HP:0040283). (ORPHA:79457)
- Abnormal blistering of the skin (HP:0008066): The presence of one or more bullae on the skin, defined as fluid-filled blisters more than 5 mm in diameter with thin walls. Evidence: TAS. Frequency: Occasional (HP:0040283). (ORPHA:79457)
- Dermatographic urticaria (HP:0011971): An exaggerated whealing tendency when the skin is stroked, that is, formation of red, itchy bumps and lines on the skin as a result of pressure on the skin (for instance, stroking the skin with a pen or tongue depressor). Evidence: TAS. Frequency: Occasional (HP:0040283). (ORPHA:79457)
- Adverse drug response (HP:0020172): An unpleasant or harmful reaction resulting from treatment with a drug. Evidence: TAS. Frequency: Occasional (HP:0040283). (ORPHA:79457)
- Flushing (HP:0031284): Recurrent episodes of redness of the skin together with a sensation of warmth or burning of the affected areas of skin. Evidence: TAS. Frequency: Occasional (HP:0040283). (ORPHA:79457)
- Elevated total serum tryptase (HP:0031901): An abnormally elevated concentration of total tryptase (alpha and beta tryptase) in the blood circulation. Evidence: TAS. Frequency: Occasional (HP:0040283). (ORPHA:79457)
- Dyspnea (HP:0002094): Difficult or labored breathing. Dyspnea is a subjective feeling only the patient can rate, e.g., on a Borg scale. Evidence: TAS. Frequency: Very rare (HP:0040284). (ORPHA:79457)
These phenotypes are associated with the disease Maculopapular cutaneous mastocytosis (ORPHA:79457).